Phenotypes associated with the disease familial meningioma (OMIM:607174):
- Adult onset (HP:0003581): Onset of disease manifestations in adulthood, defined here as at the age of 16 years or later. Evidence: TAS. (OMIM:607174)
- Typified by incomplete penetrance (HP:0003829): Description of conditions in which not all individuals with a given genotype exhibit the disease. Penetrance is the proportion that develop disease given a lifespan of 80 years. Evidence: TAS. (OMIM:607174)
- Meningioma (HP:0002858): The presence of a meningioma, i.e., a benign tumor originating from the dura mater or arachnoid mater. Evidence: TAS. (OMIM:607174)
- Autosomal dominant inheritance (HP:0000006): A mode of inheritance that is observed for traits related to a gene encoded on one of the autosomes (i.e., the human chromosomes 1-22) in which a trait manifests in heterozygotes. In the context of medical genetics, an autosomal dominant disorder is caused when a single copy of the mutant allele is present. Males and females are affected equally, and can both transmit the disorder with a risk of 50% for each child of inheriting the mutant allele. Evidence: TAS. (OMIM:607174)